- X-linked recessive inheritance (HP:0001419): A mode of inheritance that is observed for recessive traits related to a gene encoded on the X chromosome. In the context of medical genetics, X-linked recessive disorders manifest in males (who have one copy of the X chromosome and are thus hemizygotes), but generally not in female heterozygotes who have one mutant and one normal allele. Evidence: TAS. (OMIM:307830)
- Hypouricemia (HP:0003537): The concentration of uric acid in the blood circulation is below the lower limit of normal. Evidence: TAS. (OMIM:307830)
These phenotypes are associated with the disease hypouricemia, familial renal, due to tubular hypersecretion (OMIM:307830).